Phenotypes associated with the disease fleck corneal dystrophy (OMIM:121850):
- Photophobia (HP:0000613): Excessive sensitivity to light with the sensation of discomfort or pain in the eyes due to exposure to bright light. Evidence: IEA. (OMIM:121850)
- Speckled corneal dystrophy (HP:0007962). Evidence: IEA. (OMIM:121850)
- Autosomal dominant inheritance (HP:0000006): A mode of inheritance that is observed for traits related to a gene encoded on one of the autosomes (i.e., the human chromosomes 1-22) in which a trait manifests in heterozygotes. In the context of medical genetics, an autosomal dominant disorder is caused when a single copy of the mutant allele is present. Males and females are affected equally, and can both transmit the disorder with a risk of 50% for each child of inheriting the mutant allele. Evidence: IEA. (OMIM:121850)